- Epicanthus (HP:0000286): A fold of skin starting above the medial aspect of the upper eyelid and arching downward to cover, pass in front of and lateral to the medial canthus. Evidence: PCS. Frequency: 1/1. (PMID:29760529)
- Upslanted palpebral fissure (HP:0000582): The palpebral fissure inclination is more than two standard deviations above the mean for age (objective); or, the inclination of the palpebral fissure is greater than typical for age. Evidence: PCS. Frequency: 1/1. (PMID:30345613)
- Long philtrum (HP:0000343): Distance between nasal base and midline upper lip vermilion border more than 2 SD above the mean. Alternatively, an apparently increased distance between nasal base and midline upper lip vermilion border. Evidence: PCS. Frequency: 1/1. (PMID:30345613)
- Short stature (HP:0004322): A height below that which is expected according to age and gender norms. Although there is no universally accepted definition of short stature, many refer to "short stature" as height more than 2 standard deviations below the mean for age and gender (or below the 3rd percentile for age and gender dependent norms). Evidence: PCS. Frequency: 2/3. (PMID:31171569)
- Hypotonia (HP:0001252): Hypotonia is an abnormally low muscle tone (the amount of tension or resistance to movement in a muscle). Even when relaxed, muscles have a continuous and passive partial contraction which provides some resistance to passive stretching. Hypotonia thus manifests as diminished resistance to passive stretching. Hypotonia is not the same as muscle weakness, although the two conditions can co-exist. Evidence: PCS. Frequency: 7/7. (PMID:29760529;PMID:29892088;PMID:30345613;PMID:31171569)
- Hepatomegaly (HP:0002240): Abnormally increased size of the liver. Evidence: PCS. Frequency: 1/1. (PMID:29760529)
- Infantile onset (HP:0003593): Onset of signs or symptoms of disease between 28 days to one year of life. Evidence: IEA. Frequency: 1/1. (PMID:29760529)
- Failure to thrive (HP:0001508): Failure to thrive (FTT) refers to a child whose physical growth is substantially below the norm. Evidence: PCS. Frequency: 3/4. (PMID:30345613;PMID:31171569)
- Aggressive behavior (HP:0000718): Behavior or an act aimed at harming a person, animal, or physical property (e.g., acts of physical violence; shouting, swearing, and using harsh language; slashing someone's tires). Evidence: PCS. Frequency: 1/1. (PMID:30345613)
- Prominent forehead (HP:0011220): Forward prominence of the entire forehead, due to protrusion of the frontal bone. Evidence: PCS. Frequency: 1/3. (PMID:31171569)
- Anxiety (HP:0000739): Intense feelings of nervousness, tension, or panic often arise in response to interpersonal stresses. There is worry about the negative effects of past unpleasant experiences and future negative possibilities. Individuals may feel fearful, apprehensive, or threatened by uncertainty, and they may also have fears of falling apart or losing control. Evidence: PCS. Frequency: 1/1. (PMID:30345613)
- Chronic constipation (HP:0012450): Constipation for longer than three months with fewer than 3 bowel movements per week, straining, lumpy or hard stools, and a sensation of anorectal obstruction or incomplete defecation. Evidence: PCS. Frequency: 3/4. (PMID:30345613;PMID:31171569)
- Fetal onset (HP:0011461): Onset prior to birth but after 8 weeks of embryonic development (corresponding to a gestational age of 10 weeks). Evidence: PCS. Frequency: 6/6. (PMID:29892088;PMID:30345613;PMID:31171569)
- Hyperechogenic kidneys (HP:0004719): An increase in amplitude of waves returned in ultrasonography of the kidney, which is generally displayed as increased brightness of the signal. Evidence: PCS. Frequency: 1/3. (PMID:31171569)
- Hypertelorism (HP:0000316): Interpupillary distance more than 2 SD above the mean (alternatively, the appearance of an increased interpupillary distance or widely spaced eyes). Evidence: PCS. Frequency: 3/4. (PMID:29760529;PMID:29892088;PMID:30345613)
- Motor stereotypy (HP:0000733): Use of the same abnormal action in response to certain triggers or at random. They may be used as a way to regulate one's internal state but must otherwise have no apparent functional purpose. Evidence: PCS. Frequency: 1/1. (PMID:30345613)
- Postnatal growth retardation (HP:0008897): Slow or limited growth after birth. Evidence: PCS. Frequency: 2/3. (PMID:31171569)
- Hyperactivity (HP:0000752): Hyperactivity is a condition characterized by constant and unusually high levels of activity, even in situations where it is deemed inappropriate. Evidence: PCS. Frequency: 1/1. (PMID:30345613)
- Protruding ear (HP:0000411): Angle formed by the plane of the ear and the mastoid bone greater than the 97th centile for age (objective); or, outer edge of the helix more than 2 cm from the mastoid at the point of maximum distance (objective). Evidence: PCS. Frequency: 2/2. (PMID:29760529;PMID:30345613)
- Wide intermamillary distance (HP:0006610): A larger than usual distance between the left and right nipple. Evidence: PCS. Frequency: 1/1. (PMID:29760529)
- Intellectual disability (HP:0001249): The term intellectual disability or intellectual developmental disorder is used to describe significantly sub-average intellectual and adaptive functioning based on clinical assessment and as measured by individually administered, appropriately normed, standardized and validated tests of intellectual functioning and adaptive behavior, with onset during the developmental period from infancy through adolescence. Evidence: PCS. Frequency: 4/4. (PMID:29892088;PMID:31171569)
- Highly arched eyebrow (HP:0002553): Increased height of the central portion of the eyebrow, forming a crescent, semicircular, or inverted U shape. Evidence: PCS. Frequency: 2/3. (PMID:29892088;PMID:30345613)
- Microcephaly (HP:0000252): Head circumference below 2 standard deviations below the mean for age and gender. Evidence: PCS. Frequency: 6/6. (PMID:29760529;PMID:29892088;PMID:31171569)
- Thin vermilion border (HP:0000233): Height of the vermilion of the medial part of the lip more than 2 SD below the mean, or apparently reduced height of the vermilion of the lip in the frontal view. The vermilion is the red part of the lips (and confusingly, the vermilion itself is also often referred to as being equivalent the lips). Evidence: PCS. Frequency: 1/1. (PMID:30345613)
- Wide nasal bridge (HP:0000431): Increased breadth of the nasal bridge (and with it, the nasal root). Evidence: PCS. Frequency: 5/7. (PMID:29760529;PMID:29892088;PMID:30345613;PMID:31171569)
- Short chin (HP:0000331): Decreased vertical distance from the vermilion border of the lower lip to the inferior-most point of the chin. Evidence: PCS. Frequency: 1/1. (PMID:30345613)
- Miscarriage (HP:0005268): A pregnancy that ends at a stage in which the fetus is incapable of surviving on its own, defined as the spontaneous loss of a fetus before the 22th week of pregnancy. Evidence: PCS. Frequency: 1/1. (PMID:29760529)
- Feeding difficulties (HP:0011968): Impaired ability to eat related to problems gathering food and getting ready to suck, chew, or swallow it. Evidence: PCS. Frequency: 2/2. (PMID:29892088)
- Attached earlobe (HP:0009907): Attachment of the lobe to the side of the face at the lowest point of the lobe without curving upward. Evidence: PCS. Frequency: 1/1. (PMID:29760529)
- Global developmental delay (HP:0001263): A delay in the achievement of motor or mental milestones in the domains of development of a child, including motor skills, speech and language, cognitive skills, and social and emotional skills. This term should only be used to describe children younger than five years of age. Evidence: PCS. Frequency: 5/5. (PMID:29760529;PMID:30345613;PMID:31171569)
- Depressed nasal bridge (HP:0005280): Posterior positioning of the nasal root in relation to the overall facial profile for age. Evidence: PCS. Frequency: 1/1. (PMID:30345613)
- Bilateral renal hypoplasia (HP:0012584): Two sided hypoplasia of the kidney. Evidence: PCS. Frequency: 1/3. (PMID:31171569)
- Telecanthus (HP:0000506): Distance between the inner canthi more than two standard deviations above the mean (objective); or, apparently increased distance between the inner canthi. Evidence: PCS. Frequency: 1/1. (PMID:30345613)
- Exocrine pancreatic insufficiency (HP:0001738): Impaired function of the exocrine pancreas associated with a reduced ability to digest foods because of lack of digestive enzymes. Evidence: PCS. Frequency: 1/3. (PMID:31171569)
- Autistic behavior (HP:0000729): Persistent deficits in social interaction and communication and interaction as well as a markedly restricted repertoire of activity and interest as well as repetitive patterns of behavior. Evidence: PCS. Frequency: 1/1. (PMID:31171569)
- Periorbital fullness (HP:0000629): Increase in periorbital soft tissue. Evidence: PCS. Frequency: 1/1. (PMID:30345613)
- High forehead (HP:0000348): An abnormally increased height of the forehead. Evidence: PCS. Frequency: 1/1. (PMID:29760529)
- Almond-shaped palpebral fissure (HP:0007874): A shape created by an acute downward arching of the upper eyelid and upward arching of the lower eyelid, toward the medial canthus, which gives the outline of the palpebral fissures the configuration of an almond. Thus, the maximum distance between the fissures is offset from, and medial to, the center point. Evidence: PCS. Frequency: 1/1. (PMID:30345613)
- Clinodactyly of the 5th finger (HP:0004209): Clinodactyly refers to a bending or curvature of the fifth finger in the radial direction (i.e., towards the 4th finger). Evidence: PCS. Frequency: 1/1. (PMID:29760529)
- Intrauterine growth retardation (HP:0001511): An abnormal restriction of fetal growth with fetal weight below the tenth percentile for gestational age. Evidence: PCS. Frequency: 6/6. (PMID:29892088;PMID:30345613;PMID:31171569)
- Sacral dimple (HP:0000960): A cutaneous indentation resulting from tethering of the skin to underlying structures (bone) of the intergluteal cleft. Evidence: PCS. Frequency: 1/1. (PMID:30345613)
- Short philtrum (HP:0000322): Distance between nasal base and midline upper lip vermilion border more than 2 SD below the mean. Alternatively, an apparently decreased distance between nasal base and midline upper lip vermilion border. Evidence: PCS. Frequency: 2/2. (PMID:29892088)
- Prominent crus of helix (HP:0009899): The presence of an abnormally prominent of the crus of the helix. That is, development of the crus helix to the same degree as an average antihelix stem or helix. Evidence: PCS. Frequency: 1/3. (PMID:31171569)
- Autosomal dominant inheritance (HP:0000006): A mode of inheritance that is observed for traits related to a gene encoded on one of the autosomes (i.e., the human chromosomes 1-22) in which a trait manifests in heterozygotes. In the context of medical genetics, an autosomal dominant disorder is caused when a single copy of the mutant allele is present. Males and females are affected equally, and can both transmit the disorder with a risk of 50% for each child of inheriting the mutant allele. Evidence: PCS. (PMID:29760529)
- Micrognathia (HP:0000347): Developmental hypoplasia of the mandible. Evidence: PCS. Frequency: 2/2. (PMID:29892088)
These phenotypes are associated with the disease Rauch-Steindl syndrome (OMIM:619695).